Phenotypes associated with the disease neurodevelopmental disorder with poor growth, absent speech, progressive ataxia, and dysmorphic facies (OMIM:621067):
- Decreased body weight (HP:0004325): Abnormally low body weight. Evidence: PCS. Frequency: 5/5. (PMID:37943610)
- Bilateral tonic-clonic seizure (HP:0002069): A bilateral tonic-clonic seizure is a seizure defined by a tonic (bilateral increased tone, lasting seconds to minutes) and then a clonic (bilateral sustained rhythmic jerking) phase. Evidence: PCS. Frequency: 2/2. (PMID:37943610)
- Clonus (HP:0002169): A series of rhythmic and involuntary muscle contractions (at a frequency of about 5 to 7 Hz) that occur in response to an abruptly applied and sustained stretch. Evidence: PCS. Frequency: 2/2. (PMID:37943610)
- Moderate intellectual disability (HP:0002342): Moderate intellectual disability (ID) is defined as a type of ID characterized by moderately sub-average adaptive functioning and intellectual functioning, with an intelligence quotient (IQ) the range of 35-49. Evidence: PCS. Frequency: 1/1. (PMID:37943610)
- Steppage gait (HP:0003376): An abnormal gait pattern that arises from weakness of the pretibial and peroneal muscles due to a lower motor neuron lesion. Affected patients have footdrop and are unable to dorsiflex and evert the foot. The leg is lifted high on walking so that the toes clear the ground, and there may be a slapping noise when the foot strikes the ground again. Evidence: PCS. Frequency: 2/2. (PMID:37943610)
- Short stature (HP:0004322): A height below that which is expected according to age and gender norms. Although there is no universally accepted definition of short stature, many refer to "short stature" as height more than 2 standard deviations below the mean for age and gender (or below the 3rd percentile for age and gender dependent norms). Evidence: PCS. Frequency: 5/5. (PMID:37943610)
- Dystonia (HP:0001332): An abnormally increased muscular tone that causes fixed abnormal postures. There is a slow, intermittent twisting motion that leads to exaggerated turning and posture of the extremities and trunk. Evidence: PCS. Frequency: 2/3. (PMID:37943610)
- Seizure (HP:0001250): A seizure is an intermittent abnormality of nervous system physiology characterized by a transient occurrence of signs and/or symptoms due to abnormal excessive or synchronous neuronal activity in the brain. Evidence: PCS. Frequency: 1/3. (PMID:37943610)
- Gait ataxia (HP:0002066): A type of ataxia characterized by the impairment of the ability to coordinate the movements required for normal walking. Gait ataxia is characteirzed by a wide-based staggering gait with a tendency to fall. Evidence: PCS. Frequency: 1/1. (PMID:37943610)
- Hypotonia (HP:0001252): Hypotonia is an abnormally low muscle tone (the amount of tension or resistance to movement in a muscle). Even when relaxed, muscles have a continuous and passive partial contraction which provides some resistance to passive stretching. Hypotonia thus manifests as diminished resistance to passive stretching. Hypotonia is not the same as muscle weakness, although the two conditions can co-exist. Evidence: PCS. Frequency: 1/2. (PMID:37943610)
- Ataxia (HP:0001251): Ataxia refers to impaired coordination of voluntary muscle movement. Cerebellar ataxia refers to ataxia due to dysfunction of the cerebellum. This causes a variety of elementary neurological deficits including asynergy (lack of coordination between muscles, limbs and joints), dysmetria (lack of ability to judge distances that can lead to under- or overshoot in grasping movements), and dysdiadochokinesia (inability to perform rapid movements requiring antagonizing muscle groups to be switched on and off repeatedly). Evidence: PCS. Frequency: 2/2. (PMID:37943610)
- Infantile onset (HP:0003593): Onset of signs or symptoms of disease between 28 days to one year of life. Evidence: PCS. Frequency: 5/5. (PMID:37943610)
- Motor delay (HP:0001270): A type of Developmental delay characterized by a delay in acquiring motor skills. Evidence: PCS. Frequency: 1/1. (PMID:37943610)
- Severe intellectual disability (HP:0010864): Severe intellectual disability (ID) is defined as a type of ID characterized by severely sub-average adaptive functioning and intellectual functioning, with an intelligence quotient (IQ) the range of 20-34. Evidence: PCS. Frequency: 4/4. (PMID:37943610)
- Subcortical cerebral atrophy (HP:0012157): Atrophy of the cerebral subcortical white and gray matter, termed subcortical atrophy, reflects loss of nerve cells in the basal ganglia or fibers in the deep white matter. Evidence: PCS. Frequency: 1/1. (PMID:37943610)
- Cataract (HP:0000518): A cataract is an opacity or clouding that develops in the crystalline lens of the eye or in its capsule. Evidence: PCS. Frequency: 1/2. (PMID:37943610)
- Recurrent infections (HP:0002719): Increased susceptibility to infections as manifested by repeated bouts of infection. Evidence: PCS. Frequency: 0/2. (PMID:37943610)
- Hypertelorism (HP:0000316): Interpupillary distance more than 2 SD above the mean (alternatively, the appearance of an increased interpupillary distance or widely spaced eyes). Evidence: PCS. Frequency: 0/3. (PMID:37943610)
- High palate (HP:0000218): Height of the palate more than 2 SD above the mean (objective) or palatal height at the level of the first permanent molar more than twice the height of the teeth (subjective). Evidence: PCS. Frequency: 0/3. (PMID:37943610)
- Brisk reflexes (HP:0001348): Tendon reflexes that are noticeably more active than usual (conventionally denoted 3+ on clinical examination). Brisk reflexes may or may not indicate a neurological lesion. They are distinguished from hyperreflexia by the fact that hyerreflexia is characterized by hyperactive repeating (clonic) reflexes, which are considered to be always abnormal. Evidence: PCS. Frequency: 3/4. (PMID:37943610)
- Microcephaly (HP:0000252): Head circumference below 2 standard deviations below the mean for age and gender. Evidence: PCS. Frequency: 3/5. (PMID:37943610)
- Downslanted palpebral fissures (HP:0000494): The palpebral fissure inclination is more than two standard deviations below the mean. Evidence: PCS. Frequency: 1/3. (PMID:37943610)
- Broad-based gait (HP:0002136): An abnormal gait pattern in which persons stand and walk with their feet spaced widely apart. This is often a component of cerebellar ataxia. Evidence: PCS. Frequency: 5/5. (PMID:37943610)
- Scoliosis (HP:0002650): The presence of an abnormal lateral curvature of the spine. Evidence: PCS. Frequency: 2/3. (PMID:37943610)
- Absent speech (HP:0001344): Complete lack of development of speech and language abilities. Evidence: PCS. Frequency: 4/5. (PMID:37943610)
- Delayed speech and language development (HP:0000750): A degree of language development that is significantly below the norm for a child of a specified age. Evidence: PCS. Frequency: 1/1. (PMID:37943610)
- Talipes equinovarus (HP:0001762): Talipes equinovarus (also called clubfoot) typically has four main components: inversion and adduction of the forefoot; inversion of the heel and hindfoot; equinus (limitation of extension) of the ankle and subtalar joint; and internal rotation of the leg. Evidence: PCS. Frequency: 2/4. (PMID:37943610)
- Vomiting (HP:0002013): Forceful ejection of the contents of the stomach through the mouth by means of a series of involuntary spasmic contractions. Evidence: PCS. Frequency: 0/2. (PMID:37943610)
- Babinski sign (HP:0003487): Upturning of the big toe (and sometimes fanning of the other toes) in response to stimulation of the sole of the foot. If the Babinski sign is present it can indicate damage to the corticospinal tract. Evidence: PCS. Frequency: 3/3. (PMID:37943610)
- Pes cavus (HP:0001761): An increase in height of the medial longitudinal arch of the foot that does not flatten on weight bearing (i.e., a distinctly hollow form of the sole of the foot when it is bearing weight). Evidence: PCS. Frequency: 2/4. (PMID:37943610)
- Joint hypermobility (HP:0001382): The capability that a joint (or a group of joints) has to move, passively and/or actively, beyond normal limits along physiological axes. Evidence: PCS. Frequency: 1/3. (PMID:37943610)
- Poor suck (HP:0002033): An inadequate sucking reflex, resulting in the difficult of newborns to be breast-fed. Evidence: PCS. Frequency: 1/1. (PMID:37943610)
- Global developmental delay (HP:0001263): A delay in the achievement of motor or mental milestones in the domains of development of a child, including motor skills, speech and language, cognitive skills, and social and emotional skills. This term should only be used to describe children younger than five years of age. Evidence: PCS. Frequency: 5/5. (PMID:37943610)
- Depressed nasal bridge (HP:0005280): Posterior positioning of the nasal root in relation to the overall facial profile for age. Evidence: PCS. Frequency: 0/3. (PMID:37943610)
- Increased overbite (HP:0011094): Maxillary teeth cover the mandibular teeth when biting to an increased degree. The feature is defined as a vertical overlap of the maxillary incisors over the mandibular incisors that exceeds 2 mm. Evidence: PCS. Frequency: 1/3. (PMID:37943610)
- Pectus excavatum (HP:0000767): A defect of the chest wall characterized by a depression of the sternum, giving the chest ("pectus") a caved-in ("excavatum") appearance. Evidence: PCS. Frequency: 1/3. (PMID:37943610)
- Autosomal recessive inheritance (HP:0000007): A mode of inheritance that is observed for traits related to a gene encoded on one of the autosomes (i.e., the human chromosomes 1-22) in which a trait manifests in individuals with two pathogenic alleles, either homozygotes (two copies of the same mutant allele) or compound heterozygotes (whereby each copy of a gene has a distinct mutant allele). Evidence: PCS. (PMID:37943610)
- Falls (HP:0002527). Evidence: PCS. Frequency: 2/2. (PMID:37943610)
- Spasticity (HP:0001257): A motor disorder characterized by a velocity-dependent increase in tonic stretch reflexes with increased muscle tone, exaggerated (hyperexcitable) tendon reflexes. Evidence: PCS. Frequency: 1/1. (PMID:37943610)
- Shawl scrotum (HP:0000049): Superior margin of the scrotum superior to the base of the penis. Evidence: PCS. Frequency: 1/1. (PMID:37943610)
- Immunodeficiency (HP:0002721): Failure of the immune system to protect the body adequately from infection, due to the absence or insufficiency of some component process or substance. Evidence: PCS. Frequency: 0/2. (PMID:37943610)